Phenotypes associated with the disease magnesium, elevated red cell (OMIM:248260):
- Abnormality of metabolism/homeostasis (HP:0001939). Evidence: IEA. (OMIM:248260)
- Autosomal recessive inheritance (HP:0000007): A mode of inheritance that is observed for traits related to a gene encoded on one of the autosomes (i.e., the human chromosomes 1-22) in which a trait manifests in individuals with two pathogenic alleles, either homozygotes (two copies of the same mutant allele) or compound heterozygotes (whereby each copy of a gene has a distinct mutant allele). Evidence: IEA. (OMIM:248260)